Phenotypes associated with the disease DNM1L-related encephalopathy due to mitochondrial and peroxisomal fission defect (ORPHA:330050):
- Abnormality of the mitochondrion (HP:0012103): An anomaly of the mitochondrion, the membranous cytoplasmic organelle the interior of which is subdivided by cristae. The mitochondrion is a self replicating organelle that is the site of tissue respiration. Evidence: TAS. Frequency: Very frequent (HP:0040281). (ORPHA:330050)
- Nystagmus (HP:0000639): Rhythmic, involuntary oscillations of one or both eyes related to abnormality in fixation, conjugate gaze, or vestibular mechanisms. Evidence: TAS. Frequency: Frequent (HP:0040282). (ORPHA:330050)
- Optic atrophy (HP:0000648): Atrophy of the optic nerve. Optic atrophy results from the death of the retinal ganglion cell axons that comprise the optic nerve and manifesting as a pale optic nerve on fundoscopy. Evidence: TAS. Frequency: Frequent (HP:0040282). (ORPHA:330050)
- Seizure (HP:0001250): A seizure is an intermittent abnormality of nervous system physiology characterized by a transient occurrence of signs and/or symptoms due to abnormal excessive or synchronous neuronal activity in the brain. Evidence: TAS. Frequency: Frequent (HP:0040282). (ORPHA:330050)
- Global developmental delay (HP:0001263): A delay in the achievement of motor or mental milestones in the domains of development of a child, including motor skills, speech and language, cognitive skills, and social and emotional skills. This term should only be used to describe children younger than five years of age. Evidence: TAS. Frequency: Frequent (HP:0040282). (ORPHA:330050)
- Absent speech (HP:0001344): Complete lack of development of speech and language abilities. Evidence: TAS. Frequency: Frequent (HP:0040282). (ORPHA:330050)
- Status epilepticus (HP:0002133): Status epilepticus is a type of prolonged seizure resulting either from the failure of the mechanisms responsible for seizure termination or from the initiation of mechanisms which lead to abnormally prolonged seizures (after time point t1). It is a condition that can have long-term consequences (after time point t2), including neuronal death, neuronal injury, and alteration of neuronal networks, depending on the type and duration of seizures. Evidence: TAS. Frequency: Frequent (HP:0040282). (ORPHA:330050)
- Increased circulating lactate concentration (HP:0002151): Abnormally increased level of blood lactate (2-hydroxypropanoic acid). Lactate is produced from pyruvate by lactate dehydrogenase during normal metabolism. The terms lactate and lactic acid are often used interchangeably but lactate (the component measured in blood) is strictly a weak base whereas lactic acid is the corresponding acid. Lactic acidosis is often used clinically to describe elevated lactate but should be reserved for cases where there is a corresponding acidosis (pH below 7.35). Evidence: TAS. Frequency: Frequent (HP:0040282). (ORPHA:330050)
- Developmental regression (HP:0002376): Loss of developmental skills, as manifested by loss of developmental milestones. Evidence: TAS. Frequency: Frequent (HP:0040282). (ORPHA:330050)
- Inability to walk (HP:0002540): Incapability to ambulate. Evidence: TAS. Frequency: Frequent (HP:0040282). (ORPHA:330050)
- Elevated brain lactate level by MRS (HP:0012707): An increase in the level of lactate in the brain identified by magnetic resonance spectroscopy (MRS). Evidence: TAS. Frequency: Frequent (HP:0040282). (ORPHA:330050)
- Brain imaging abnormality (HP:0410263): An anomaly of metabolism or structure of the brain identified by imaging. Evidence: TAS. Frequency: Frequent (HP:0040282). (ORPHA:330050)
- Strabismus (HP:0000486): A misalignment of the eyes so that the visual axes deviate from bifoveal fixation. The classification of strabismus may be based on a number of features including the relative position of the eyes, whether the deviation is latent or manifest, intermittent or constant, concomitant or otherwise and according to the age of onset and the relevance of any associated refractive error. Evidence: TAS. Frequency: Occasional (HP:0040283). (ORPHA:330050)
- Cerebellar atrophy (HP:0001272): Cerebellar atrophy is defined as a cerebellum with initially normal structures, in a posterior fossa with normal size, which displays enlarged fissures (interfolial spaces) in comparison to the foliae secondary to loss of tissue. Cerebellar atrophy implies irreversible loss of tissue and result from an ongoing progressive disease until a final stage is reached or a single injury, e.g. an intoxication or infectious event. Evidence: TAS. Frequency: Occasional (HP:0040283). (ORPHA:330050)
- Gait disturbance (HP:0001288): The term gait disturbance can refer to any disruption of the ability to walk. Evidence: TAS. Frequency: Occasional (HP:0040283). (ORPHA:330050)
- Dystonia (HP:0001332): An abnormally increased muscular tone that causes fixed abnormal postures. There is a slow, intermittent twisting motion that leads to exaggerated turning and posture of the extremities and trunk. Evidence: TAS. Frequency: Occasional (HP:0040283). (ORPHA:330050)
- Tremor (HP:0001337): An unintentional, oscillating to-and-fro muscle movement about a joint axis. Evidence: TAS. Frequency: Occasional (HP:0040283). (ORPHA:330050)
- Bilateral ptosis (HP:0001488). Evidence: TAS. Frequency: Occasional (HP:0040283). (ORPHA:330050)
- Bilateral tonic-clonic seizure (HP:0002069): A bilateral tonic-clonic seizure is a seizure defined by a tonic (bilateral increased tone, lasting seconds to minutes) and then a clonic (bilateral sustained rhythmic jerking) phase. Evidence: TAS. Frequency: Occasional (HP:0040283). (ORPHA:330050)
- Generalized myoclonic seizure (HP:0002123): A generalized myoclonic seizure is a type of generalized motor seizure characterized by bilateral, sudden, brief (<100 ms) involuntary single or multiple contraction of muscles or muscle groups of variable topography (axial, proximal limb, distal). Myoclonus is less regularly repetitive and less sustained than is clonus. Evidence: TAS. Frequency: Occasional (HP:0040283). (ORPHA:330050)
- Aphasia (HP:0002381): An acquired language impairment of some or all of the abilities to produce or comprehend speech and to read or write. Evidence: TAS. Frequency: Occasional (HP:0040283). (ORPHA:330050)
- Focal impaired awareness seizure (HP:0002384): Focal impaired awareness seizure (or focal seizure with impaired or lost awareness) is a type of focal-onset seizure characterized by some degree (which may be partial) of impairment of the person's awareness of themselves or their surroundings at any point during the seizure. Evidence: TAS. Frequency: Occasional (HP:0040283). (ORPHA:330050)
- Diffuse cerebral atrophy (HP:0002506): Diffuse unlocalised atrophy affecting the cerebrum. Evidence: TAS. Frequency: Occasional (HP:0040283). (ORPHA:330050)
- Scoliosis (HP:0002650): The presence of an abnormal lateral curvature of the spine. Evidence: TAS. Frequency: Occasional (HP:0040283). (ORPHA:330050)
- Skeletal muscle atrophy (HP:0003202): The presence of skeletal muscular atrophy (which is also known as amyotrophy). Evidence: TAS. Frequency: Occasional (HP:0040283). (ORPHA:330050)
- Hyperactive deep tendon reflexes (HP:0006801). Evidence: TAS. Frequency: Occasional (HP:0040283). (ORPHA:330050)
- Focal-onset seizure (HP:0007359): A focal-onset seizure is a type of seizure originating within networks limited to one hemisphere. They may be discretely localized or more widely distributed, and may originate in subcortical structures. Evidence: TAS. Frequency: Occasional (HP:0040283). (ORPHA:330050)
- Oculogyric crisis (HP:0010553): An acute dystonic reaction with blepharospasm, periorbital twitches, and protracted fixed staring episodes. There may be a maximal upward deviation of the eyes in the sustained fashion. Oculogyric crisis can be triggered by a number of factors including neuroleptic medications. Evidence: TAS. Frequency: Occasional (HP:0040283). (ORPHA:330050)
- Gastrostomy tube feeding in infancy (HP:0011471): Feeding problem necessitating gastrostomy tube feeding. Evidence: TAS. Frequency: Occasional (HP:0040283). (ORPHA:330050)
- Delayed menarche (HP:0012569): First period after the age of 15 years. Evidence: TAS. Frequency: Occasional (HP:0040283). (ORPHA:330050)